- Positive blood 1,3 beta glucan test (HP:0020153): Beta-1,3-glucan is a major constituent of all of the characterized fungal cell walls, making up between 30-80 percent of the mass of the wall. It is a biomarker of fungal infections such as invasive pulmonary aspergillosis. Evidence: TAS. Frequency: Very frequent (HP:0040281). (ORPHA:228119)
- Sinusitis (HP:0000246): Inflammation of the paranasal sinuses owing to a viral, bacterial, or fungal infection, allergy, or an autoimmune reaction. Evidence: TAS. Frequency: Frequent (HP:0040282). (ORPHA:228119)
- Decreased total neutrophil count (HP:0001875): Abnormal decrease of absolute number of neutrophils in the blood, per microlitre, compared to a reference range for a given sex and age-group. Evidence: TAS. Frequency: Frequent (HP:0040282). (ORPHA:228119)
- Fever (HP:0001945): Body temperature elevated above the normal range. Evidence: TAS. Frequency: Frequent (HP:0040282). (ORPHA:228119)
- Pneumonia (HP:0002090): Inflammation of any part of the lung parenchyma. Evidence: TAS. Frequency: Frequent (HP:0040282). (ORPHA:228119)
- Immunodeficiency (HP:0002721): Failure of the immune system to protect the body adequately from infection, due to the absence or insufficiency of some component process or substance. Evidence: TAS. Frequency: Frequent (HP:0040282). (ORPHA:228119)
- Regional abnormality of skin (HP:0011356): An abnormality of the skin that is restricted to a particular body region. Evidence: TAS. Frequency: Frequent (HP:0040282). (ORPHA:228119)
- Unusual fungal nail infection (HP:0012203): Increased susceptibility to fungal infection of the nail apparatus (onychomycosis), as manifested by recurrent or severe infection of the nail plate, nail bed, or nail matrix caused by fungal organisms. Causative agents include dermatophytes (Trichophyton species) and Candida species. Evidence: TAS. Frequency: Frequent (HP:0040282). (ORPHA:228119)
- Invasive fungal infection (HP:0020101): Fungal infection characterized by invasion of host tissues. Evidence: TAS. Frequency: Frequent (HP:0040282). (ORPHA:228119)
- Subcutaneous nodule (HP:0001482): Slightly elevated lesions on or in the skin with a diameter of over 5 mm. Evidence: TAS. Frequency: Occasional (HP:0040283). (ORPHA:228119)
- Paronychia (HP:0001818): The nail disease paronychia is an often-tender bacterial or fungal hand infection or foot infection where the nail and skin meet at the side or the base of a finger or toenail. The infection can start suddenly (acute paronychia) or gradually (chronic paronychia). Evidence: TAS. Frequency: Occasional (HP:0040283). (ORPHA:228119)
- Decreased total lymphocyte count (HP:0001888): A reduced number of lymphocytes in the blood. Evidence: TAS. Frequency: Occasional (HP:0040283). (ORPHA:228119)
- Hemoptysis (HP:0002105): Coughing up (expectoration) of blood or blood-streaked sputum from the larynx, trachea, bronchi, or lungs. Evidence: TAS. Frequency: Occasional (HP:0040283). (ORPHA:228119)
- Pulmonary infiltrates (HP:0002113). Evidence: TAS. Frequency: Occasional (HP:0040283). (ORPHA:228119)
- Pleural effusion (HP:0002202): The presence of an excessive amount of fluid in the pleural cavity. Evidence: TAS. Frequency: Occasional (HP:0040283). (ORPHA:228119)
- Myalgia (HP:0003326): Pain in muscle. Evidence: TAS. Frequency: Occasional (HP:0040283). (ORPHA:228119)
- Hematological neoplasm (HP:0004377): Neoplasms located in the blood and blood-forming tissue (the bone marrow and lymphatic tissue). Evidence: TAS. Frequency: Occasional (HP:0040283). (ORPHA:228119)
- Hypersensitivity pneumonitis (HP:0006516): Hypersensitivity pneumonitis involves inhalation of an antigen. This leads to an exaggerated immune response and a following inflammation of the alveoli within the lungs. The main feature of chronic hypersensitivity pneumonitis on lung biopsies is expansion of the interstitium by lymphocytes accompanied by an occasional multinucleated giant cell or loose granuloma. After exposure to the provoking antigen, following symptoms can be seen: fever, chills, malaise, cough, hemoptysis, chest tightness, dyspnea, rash, swelling and headache and can be completely reversible, based on the duration of the illness, categorized as acute (HP:0011009), subacute (HP:0011011), and chronic (HP:0011010). Evidence: TAS. Frequency: Occasional (HP:0040283). (ORPHA:228119)
- Ground-glass opacification (HP:0025179): On chest radiographs, ground-glass opacity appears as an area of hazy increased lung opacity, usually extensive, within which margins of pulmonary vessels may be indistinct. On CT scans, it appears as hazy increased opacity of lung, with preservation of bronchial and vascular margins. It is caused by partial filling of airspaces, interstitial thickening (due to fluid, cells, and/or fibrosis), partial collapse of alveoli, increased capillary blood volume, or a combination of these, the common factor being the partial displacement of air. Ground-glass opacity is less opaque than consolidation, in which bronchovascular margins are obscured. Evidence: TAS. Frequency: Occasional (HP:0040283). (ORPHA:228119)
- Productive cough (HP:0031245): A cough that produces phlegm or mucus. Evidence: TAS. Frequency: Occasional (HP:0040283). (ORPHA:228119)
- Pulmonary opacity (HP:0031457): Opacity refers to any area that preferentially attenuates the x-ray beam and therefore appears more opaque than the surrounding area. It is a nonspecific term that does not indicate the size or pathologic nature of the abnormality. Evidence: TAS. Frequency: Occasional (HP:0040283). (ORPHA:228119)
- Parenchymal consolidation (HP:0032177): Consolidation refers to an exudate or other product of disease that replaces alveolar air, rendering the lung solid (as in infective pneumonia). Evidence: TAS. Frequency: Occasional (HP:0040283). (ORPHA:228119)
- Granuloma (HP:0032252): A compact, organized collection of mature mononuclear phagocytes, which may be but is not necessarily accompanied by accessory features such as necrosis. Evidence: TAS. Frequency: Occasional (HP:0040283). (ORPHA:228119)
- Maculopapular exanthema (HP:0040186): A skin rash that is characterized by diffuse cutaneous erythema with areas of skin elevation. It may evolve to vesicles or papules as part of a more severe clinical entity. Different degrees of angioedema with involvement of subcutaneous tissue may also appear. Evidence: TAS. Frequency: Occasional (HP:0040283). (ORPHA:228119)
- Chest pain (HP:0100749): An unpleasant sensation characterized by physical discomfort (such as pricking, throbbing, or aching) localized to the chest. Evidence: TAS. Frequency: Occasional (HP:0040283). (ORPHA:228119)
- Papule (HP:0200034): A circumscribed, solid elevation of skin with no visible fluid, varying in size from a pinhead to less than 10mm in diameter at the widest point. Evidence: TAS. Frequency: Occasional (HP:0040283). (ORPHA:228119)
- Skin ulcer (HP:0200042): A discontinuity of the skin exhibiting complete loss of the epidermis and often portions of the dermis and even subcutaneous fat. Evidence: TAS. Frequency: Occasional (HP:0040283). (ORPHA:228119)
- Abnormality of the kidney (HP:0000077): An abnormality of the kidney. Evidence: TAS. Frequency: Very rare (HP:0040284). (ORPHA:228119)
- Abnormal retinal morphology (HP:0000479): A structural abnormality of the retina. Evidence: TAS. Frequency: Very rare (HP:0040284). (ORPHA:228119)
- Keratitis (HP:0000491): Inflammation of the cornea. Evidence: TAS. Frequency: Very rare (HP:0040284). (ORPHA:228119)
- Arthritis (HP:0001369): Inflammation of a joint. Evidence: TAS. Frequency: Very rare (HP:0040284). (ORPHA:228119)
- Abnormality of the liver (HP:0001392): An abnormality of the liver. Evidence: TAS. Frequency: Very rare (HP:0040284). (ORPHA:228119)
- Abnormality of the spleen (HP:0001743): An abnormality of the spleen. Evidence: TAS. Frequency: Very rare (HP:0040284). (ORPHA:228119)
- Bronchiectasis (HP:0002110): Persistent abnormal dilatation of the bronchi owing to localized and irreversible destruction and widening of the large airways. Evidence: TAS. Frequency: Very rare (HP:0040284). (ORPHA:228119)
- Peritonitis (HP:0002586): Inflammation of the peritoneum. Evidence: TAS. Frequency: Very rare (HP:0040284). (ORPHA:228119)
- Osteomyelitis (HP:0002754): Osteomyelitis is an inflammatory process accompanied by bone destruction and caused by an infecting microorganism. Evidence: TAS. Frequency: Very rare (HP:0040284). (ORPHA:228119)
- Abnormal blistering of the skin (HP:0008066): The presence of one or more bullae on the skin, defined as fluid-filled blisters more than 5 mm in diameter with thin walls. Evidence: TAS. Frequency: Very rare (HP:0040284). (ORPHA:228119)
- Unusual CNS infection (HP:0011450): Increased susceptibility to infections of the central nervous system, as manifested by recurrent, severe, or invasive infections involving the brain, meninges, or spinal cord. This can include infections caused by opportunistic or atypical pathogens, or common pathogens presenting with unusual severity or in anatomical locations. Evidence: TAS. Frequency: Very rare (HP:0040284). (ORPHA:228119)
- Panniculitis (HP:0012490): Inflammation of subcutaneous adipose tissue. Evidence: TAS. Frequency: Very rare (HP:0040284). (ORPHA:228119)
- Lung abscess (HP:0025044): A circumscribed area of pus or necrotic debris in lung parenchyma, which leads to a cavity, and after formation of bronchopulmonary fistula, can manifest as an air-fluid level inside the cavity. Evidence: TAS. Frequency: Very rare (HP:0040284). (ORPHA:228119)
- Brain abscess (HP:0030049): A collection of pus, immune cells, and other material in the brain. Evidence: TAS. Frequency: Very rare (HP:0040284). (ORPHA:228119)
- Skin detachment (HP:0032156): Loss of sections of skin either spontaneously or after gentle handling. Evidence: TAS. Frequency: Very rare (HP:0040284). (ORPHA:228119)
- Air crescent (HP:0033661): An air crescent is a collection of air in a crescentic shape that separates the wall of a cavity from an inner mass. The air crescent sign is often considered characteristic of either Aspergillus colonization of preexisting cavities or retraction of infarcted lung in angioinvasive aspergillosis. However, the air crescent sign has also been reported in other conditions, including tuberculosis, Wegener granulomatosis, intracavitary hemorrhage, and lung cancer. The crescent can be seen in both plain X-ray and CT scan. Evidence: TAS. Frequency: Very rare (HP:0040284). (ORPHA:228119)
- Fasciitis (HP:0100537): Inflammation of fascia, the tissue under the skin and over the muscle. Evidence: TAS. Frequency: Very rare (HP:0040284). (ORPHA:228119)
- Myositis (HP:0100614): A general term for inflammation of the muscles without respect to the underlying cause. Evidence: TAS. Frequency: Very rare (HP:0040284). (ORPHA:228119)
- Cellulitis (HP:0100658): A bacterial infection and inflammation of the skin und subcutaneous tissues. Evidence: TAS. Frequency: Very rare (HP:0040284). (ORPHA:228119)
- Otitis externa (HP:0410017): Inflammation or infection of the external auditory canal (EAC), the auricle, or both. Evidence: TAS. Frequency: Very rare (HP:0040284). (ORPHA:228119)
These phenotypes are associated with the disease Fusariosis (ORPHA:228119).